- Absent eyelashes (HP:0000561): Lack of eyelashes. Evidence: TAS. Frequency: Very frequent (HP:0040281). (ORPHA:701)
- Absent eyebrow (HP:0002223): Absence of the eyebrow. Evidence: TAS. Frequency: Very frequent (HP:0040281). (ORPHA:701)
- Patchy alopecia (HP:0002232): Transient, non-scarring hair loss and preservation of the hair follicle located in in well-defined patches. Evidence: TAS. Frequency: Very frequent (HP:0040281). (ORPHA:701)
- Alopecia universalis (HP:0002289): Loss of all hair on the entire body. Evidence: TAS. Frequency: Very frequent (HP:0040281). (ORPHA:701)
- Abnormality of the thyroid gland (HP:0000820): An abnormality of the thyroid gland. Evidence: TAS. Frequency: Occasional (HP:0040283). (ORPHA:701)
- Hypertension (HP:0000822): The presence of chronic increased pressure in the systemic arterial system. Evidence: TAS. Frequency: Occasional (HP:0040283). (ORPHA:701)
- Atopic dermatitis (HP:0001047): Atopic dermatitis (AD) or atopic eczema is an itchy, inflammatory skin condition with a predilection for the skin flexures. It is characterized by poorly defined erythema with edema, vesicles, and weeping in the acute stage and skin thickening (lichenification) in the chronic stage. Evidence: TAS. Frequency: Occasional (HP:0040283). (ORPHA:701)
- Abnormal nail morphology (HP:0001597): Abnormal structure or appearance of the nail. Evidence: TAS. Frequency: Occasional (HP:0040283). (ORPHA:701)
- Autoimmunity (HP:0002960): The occurrence of an immune reaction against the organism's own cells or tissues. Evidence: TAS. Frequency: Occasional (HP:0040283). (ORPHA:701)
- Abnormal circulating lipid concentration (HP:0003119): Any deviation from the normal concentration of a lipid in the blood circulation. Evidence: TAS. Frequency: Occasional (HP:0040283). (ORPHA:701)
- Vitiligo (HP:0001045). Evidence: TAS. Frequency: Very rare (HP:0040284). (ORPHA:701)
- Psoriasiform dermatitis (HP:0003765): A skin abnormality characterized by redness and irritation, with thick, red skin that displays flaky, silver-white patches (scales). Evidence: TAS. Frequency: Very rare (HP:0040284). (ORPHA:701)
- Type I diabetes mellitus (HP:0100651): A chronic condition in which the pancreas produces little or no insulin. Type I diabetes mellitus is manifested by the sudden onset of severe hyperglycemia with rapid progression to diabetic ketoacidosis unless treated with insulin. Evidence: TAS. Frequency: Very rare (HP:0040284). (ORPHA:701)
These phenotypes are associated with the disease Alopecia universalis (ORPHA:701).